- Open angle glaucoma (HP:0012108): A type of glaucoma defined by an open, normal appearing anterior chamber angle and raised intraocular pressure,. Evidence: TAS. (OMIM:609887)
This phenotype is associated with the disease Glaucoma 1, open angle, G (OMIM:609887).